- Diarrhea (HP:0002014): Abnormally increased frequency (usually defined as three or more) loose or watery bowel movements a day. Evidence: IEA. Frequency: 9/9. Onset: Congenital onset (HP:0003577). (PMID:31217582)
- Villous atrophy (HP:0011473): The enteric villi are atrophic or absent. Evidence: PCS. Frequency: 3/9. (PMID:31217582)
- Autosomal recessive inheritance (HP:0000007): A mode of inheritance that is observed for traits related to a gene encoded on one of the autosomes (i.e., the human chromosomes 1-22) in which a trait manifests in individuals with two pathogenic alleles, either homozygotes (two copies of the same mutant allele) or compound heterozygotes (whereby each copy of a gene has a distinct mutant allele). Evidence: PCS. (PMID:31217582)
These phenotypes are associated with the disease diarrhea 11, malabsorptive, congenital (OMIM:618662).